- Abnormality of the ear (HP:0000598): An abnormality of the ear. Evidence: IEA. (OMIM:165670)
- Autosomal dominant inheritance (HP:0000006): A mode of inheritance that is observed for traits related to a gene encoded on one of the autosomes (i.e., the human chromosomes 1-22) in which a trait manifests in heterozygotes. In the context of medical genetics, an autosomal dominant disorder is caused when a single copy of the mutant allele is present. Males and females are affected equally, and can both transmit the disorder with a risk of 50% for each child of inheriting the mutant allele. Evidence: IEA. (OMIM:165670)
These phenotypes are associated with the disease ossified ear cartilages (OMIM:165670).